Phenotypes associated with the disease coracoclavicular joint, anomalous (OMIM:121350):
- Abnormal joint morphology (HP:0001367): An abnormal structure or form of the joints, i.e., one or more of the articulations where two bones join. Evidence: IEA. (OMIM:121350)
- Autosomal dominant inheritance (HP:0000006): A mode of inheritance that is observed for traits related to a gene encoded on one of the autosomes (i.e., the human chromosomes 1-22) in which a trait manifests in heterozygotes. In the context of medical genetics, an autosomal dominant disorder is caused when a single copy of the mutant allele is present. Males and females are affected equally, and can both transmit the disorder with a risk of 50% for each child of inheriting the mutant allele. Evidence: IEA. (OMIM:121350)